Phenotypes associated with the disease intellectual disability, autosomal dominant 2 (OMIM:614113):
- Prominent fingertip pads (HP:0001212): A soft tissue prominence of the ventral aspects of the fingertips. The term "persistent fetal fingertip pads" is often used as a synonym, but should better not be used because it implies knowledge of history of the patient which often does not exist. Evidence: PCS. Frequency: 1/2. (PMID:18060736)
- Delayed speech and language development (HP:0000750): A degree of language development that is significantly below the norm for a child of a specified age. Evidence: PCS. Frequency: 2/2. (PMID:18060736)
- Absent speech (HP:0001344): Complete lack of development of speech and language abilities. Evidence: PCS. Frequency: 1/2. (PMID:18060736)
- Seizure (HP:0001250): A seizure is an intermittent abnormality of nervous system physiology characterized by a transient occurrence of signs and/or symptoms due to abnormal excessive or synchronous neuronal activity in the brain. Evidence: PCS. Frequency: 1/2. (PMID:18060736)
- Deeply set eye (HP:0000490): An eye that is more deeply recessed into the plane of the face than is typical. Evidence: PCS. Frequency: 1/2. (PMID:18060736)
- Childhood onset (HP:0011463): Onset of disease at the age of between 1 and 5 years. Evidence: PCS. Frequency: 2/2. (PMID:18060736)
- Global developmental delay (HP:0001263): A delay in the achievement of motor or mental milestones in the domains of development of a child, including motor skills, speech and language, cognitive skills, and social and emotional skills. This term should only be used to describe children younger than five years of age. Evidence: PCS. Frequency: 2/2. (PMID:18060736)
- Cholesteatoma (HP:0009797): Cholesteatoma is a benign but potentially destructive growth consisting of keratinizing epithelium located in the middle ear and/or mastoid process. In cholesteatoma, a skin cyst grows into the middle ear and mastoid. The cyst is not cancerous but can erode tissue and cause destruction of the ear. Evidence: PCS. Frequency: 1/2. (PMID:18060736)
- Midface retrusion (HP:0011800): Posterior positions and/or vertical shortening of the infraorbital and perialar regions, or increased concavity of the face and/or reduced nasolabial angle. Evidence: PCS. Frequency: 1/2. (PMID:18060736)
- Prominent supraorbital ridges (HP:0000336): Greater than average forward and/or lateral protrusion of the supraorbital portion of the frontal bones. Evidence: PCS. Frequency: 1/2. (PMID:18060736)
- Intellectual disability (HP:0001249): The term intellectual disability or intellectual developmental disorder is used to describe significantly sub-average intellectual and adaptive functioning based on clinical assessment and as measured by individually administered, appropriately normed, standardized and validated tests of intellectual functioning and adaptive behavior, with onset during the developmental period from infancy through adolescence. Evidence: PCS. Frequency: 2/2. (PMID:18060736)
- Autosomal dominant inheritance (HP:0000006): A mode of inheritance that is observed for traits related to a gene encoded on one of the autosomes (i.e., the human chromosomes 1-22) in which a trait manifests in heterozygotes. In the context of medical genetics, an autosomal dominant disorder is caused when a single copy of the mutant allele is present. Males and females are affected equally, and can both transmit the disorder with a risk of 50% for each child of inheriting the mutant allele. Evidence: PCS. (PMID:18060736)